- Decreased motor nerve conduction velocity (HP:0003431): A type of decreased nerve conduction velocity that affects the motor neuron. Evidence: IEA. (DECIPHER:29)
- Pes cavus (HP:0001761): An increase in height of the medial longitudinal arch of the foot that does not flatten on weight bearing (i.e., a distinctly hollow form of the sole of the foot when it is bearing weight). Evidence: IEA. (DECIPHER:29)
- Abnormal motor neuron morphology (HP:0002450): Any structural anomaly that affects the motor neuron. Evidence: IEA. (DECIPHER:29)
- Impaired vibratory sensation (HP:0002495): A decrease in the ability to perceive vibration. Clinically, this is usually tested with a tuning fork which vibrates at 128 Hz and is applied to bony prominences such as the malleoli at the ankles or the metacarpal-phalangeal joints. There is a slow decay of vibration from the tuning fork. The degree of vibratory sense loss can be crudely estimated by counting the number of seconds that the examiner can perceive the vibration longer than the patient. Evidence: IEA. (DECIPHER:29)
- Impaired temperature sensation (HP:0010829): A reduced ability to discriminate between different temperatures. Evidence: IEA. (DECIPHER:29)
- Hypertrophic nerve changes (HP:0003382). Evidence: IEA. (DECIPHER:29)
- Impaired proprioception (HP:0010831): A loss or impairment of the sensation of the relative position of parts of the body and joint position. Evidence: IEA. (DECIPHER:29)
- Impaired pain sensation (HP:0007328): Reduced ability to perceive painful stimuli. Evidence: IEA. (DECIPHER:29)
These phenotypes are associated with the disease Charcot-Marie-Tooth disease type 1A (DECIPHER:29).